Phenotypes associated with the disease Mietens syndrome (ORPHA:2557):
- Strabismus (HP:0000486): A misalignment of the eyes so that the visual axes deviate from bifoveal fixation. The classification of strabismus may be based on a number of features including the relative position of the eyes, whether the deviation is latent or manifest, intermittent or constant, concomitant or otherwise and according to the age of onset and the relevance of any associated refractive error. Evidence: TAS. Frequency: Very frequent (HP:0040281). (ORPHA:2557)
- Nystagmus (HP:0000639): Rhythmic, involuntary oscillations of one or both eyes related to abnormality in fixation, conjugate gaze, or vestibular mechanisms. Evidence: TAS. Frequency: Very frequent (HP:0040281). (ORPHA:2557)
- Intellectual disability (HP:0001249): The term intellectual disability or intellectual developmental disorder is used to describe significantly sub-average intellectual and adaptive functioning based on clinical assessment and as measured by individually administered, appropriately normed, standardized and validated tests of intellectual functioning and adaptive behavior, with onset during the developmental period from infancy through adolescence. Evidence: TAS. Frequency: Very frequent (HP:0040281). (ORPHA:2557)
- Global developmental delay (HP:0001263): A delay in the achievement of motor or mental milestones in the domains of development of a child, including motor skills, speech and language, cognitive skills, and social and emotional skills. This term should only be used to describe children younger than five years of age. Evidence: TAS. Frequency: Very frequent (HP:0040281). (ORPHA:2557)
- Specific learning disability (HP:0001328): Impairment of certain skills such as reading or writing, coordination, self-control, or attention that interfere with the ability to learn. The impairment is not related to a global deficiency of intelligence. Evidence: TAS. Frequency: Very frequent (HP:0040281). (ORPHA:2557)
- Joint stiffness (HP:0001387): Joint stiffness is a perceived sensation of tightness in a joint or joints when attempting to move them after a period of inactivity. Joint stiffness typically subsides over time. Evidence: TAS. Frequency: Very frequent (HP:0040281). (ORPHA:2557)
- Mutism (HP:0002300): Complete lack of speech or verbal communication in a person despite attempts to engage in conversation. Mutism as a phenomena assumes the individual has previous capacity for speech and in the pediatric population it assumes that the person is past the age of typical language development. Evidence: TAS. Frequency: Very frequent (HP:0040281). (ORPHA:2557)
- Aphasia (HP:0002381): An acquired language impairment of some or all of the abilities to produce or comprehend speech and to read or write. Evidence: TAS. Frequency: Very frequent (HP:0040281). (ORPHA:2557)
- Hypoplasia of the radius (HP:0002984): Underdevelopment of the radius. Evidence: TAS. Frequency: Very frequent (HP:0040281). (ORPHA:2557)
- Hypoplasia of the ulna (HP:0003022): Underdevelopment of the ulna. Evidence: TAS. Frequency: Very frequent (HP:0040281). (ORPHA:2557)
- Elbow dislocation (HP:0003042): Dislocation of the distal humerus out of the elbow joint, where the radius, ulna, and humerus meet. Evidence: TAS. Frequency: Very frequent (HP:0040281). (ORPHA:2557)
- Short nose (HP:0003196): Distance from nasion to subnasale more than two standard deviations below the mean, or alternatively, an apparently decreased length from the nasal root to the nasal tip. Evidence: TAS. Frequency: Very frequent (HP:0040281). (ORPHA:2557)
- Severe short stature (HP:0003510): A severe degree of short stature, more than -4 SD from the mean corrected for age and sex. Evidence: TAS. Frequency: Very frequent (HP:0040281). (ORPHA:2557)
- Corneal opacity (HP:0007957): A reduction of corneal clarity. Evidence: TAS. Frequency: Very frequent (HP:0040281). (ORPHA:2557)
- Echolalia (HP:0010529): Echolalia is the automatic imitative repetition of sounds, words, or phrases in the absence of explicit awareness. The repeated words or phrases are typically odd or used in a non-social manner. These can be words or phrases that the affected individual has heard or invented. Evidence: TAS. Frequency: Very frequent (HP:0040281). (ORPHA:2557)
- High forehead (HP:0000348): An abnormally increased height of the forehead. Evidence: TAS. Frequency: Frequent (HP:0040282). (ORPHA:2557)
- Wide nasal bridge (HP:0000431): Increased breadth of the nasal bridge (and with it, the nasal root). Evidence: TAS. Frequency: Frequent (HP:0040282). (ORPHA:2557)
- Wide nose (HP:0000445): Interalar distance more than two standard deviations above the mean for age, i.e., an apparently increased width of the nasal base and alae. Evidence: TAS. Frequency: Frequent (HP:0040282). (ORPHA:2557)
- Elbow ankylosis (HP:0003070). Evidence: TAS. Frequency: Frequent (HP:0040282). (ORPHA:2557)
- Clinodactyly of the 5th finger (HP:0004209): Clinodactyly refers to a bending or curvature of the fifth finger in the radial direction (i.e., towards the 4th finger). Evidence: TAS. Frequency: Frequent (HP:0040282). (ORPHA:2557)
- Microcephaly (HP:0000252): Head circumference below 2 standard deviations below the mean for age and gender. Evidence: TAS. Frequency: Occasional (HP:0040283). (ORPHA:2557)
- Microcornea (HP:0000482): A congenital abnormality of the cornea in which the cornea and the anterior segment of the eye are smaller than normal. The horizontal diameter of the cornea does not reach 10 mm even in adulthood. Evidence: TAS. Frequency: Occasional (HP:0040283). (ORPHA:2557)
- Cataract (HP:0000518): A cataract is an opacity or clouding that develops in the crystalline lens of the eye or in its capsule. Evidence: TAS. Frequency: Occasional (HP:0040283). (ORPHA:2557)
- Sclerocornea (HP:0000647): A congenital anomaly in which a part or the whole of the cornea acquires the characteristics of sclera, resulting in clouding of the cornea. Evidence: TAS. Frequency: Occasional (HP:0040283). (ORPHA:2557)
- Hip dysplasia (HP:0001385): The presence of developmental dysplasia of the hip. Evidence: TAS. Frequency: Occasional (HP:0040283). (ORPHA:2557)
- Metatarsus adductus (HP:0001840): The metatarsals are deviated medially (tibially), that is, the bones in the front half of the foot bend or turn in toward the body. Evidence: TAS. Frequency: Occasional (HP:0040283). (ORPHA:2557)
- Talipes (HP:0001883): A deformity of foot and ankle that has different subtypes that are talipes equinovarus, talipes equinovalgus, talipes calcaneovarus and talipes calcaneovalgus. Evidence: TAS. Frequency: Occasional (HP:0040283). (ORPHA:2557)
- Coxa valga (HP:0002673): Coxa valga is a deformity of the hip in which the angle between the femoral shaft and the femoral neck is increased compared to age-adjusted values (about 150 degrees in newborns gradually reducing to 120-130 degrees in adults). Evidence: TAS. Frequency: Occasional (HP:0040283). (ORPHA:2557)
- Coxa vara (HP:0002812): Coxa vara includes all forms of decrease of the femoral neck shaft angle (the angle between the neck and the shaft of the femur) to less than 120 degrees. Evidence: TAS. Frequency: Occasional (HP:0040283). (ORPHA:2557)
- Hip dislocation (HP:0002827): Displacement of the femur from its normal location in the hip joint. Evidence: TAS. Frequency: Occasional (HP:0040283). (ORPHA:2557)
- Abnormal fibula morphology (HP:0002991): An anomaly of the calf bone (fibula), one of the two bones of the calf. Evidence: TAS. Frequency: Occasional (HP:0040283). (ORPHA:2557)
- Avascular necrosis of the capital femoral epiphysis (HP:0005743): Avascular necrosis of the proximal epiphysis of the femur occurring in growing children and caused by an interruption of the blood supply to the head of the femur close to the hip joint. The necrosis is characteristically associated with flattening of the femoral head, for which reason the term coxa plana has been used to refer to this feature in the medical literature. Evidence: TAS. Frequency: Occasional (HP:0040283). (ORPHA:2557)